- Hearing impairment (HP:0000365): A decreased magnitude of the sensory perception of sound. Evidence: IEA. (OMIM:191200)
- Autosomal dominant inheritance (HP:0000006): A mode of inheritance that is observed for traits related to a gene encoded on one of the autosomes (i.e., the human chromosomes 1-22) in which a trait manifests in heterozygotes. In the context of medical genetics, an autosomal dominant disorder is caused when a single copy of the mutant allele is present. Males and females are affected equally, and can both transmit the disorder with a risk of 50% for each child of inheriting the mutant allele. Evidence: IEA. (OMIM:191200)
These phenotypes are associated with the disease tune deafness (OMIM:191200).